- Progressive (HP:0003676): Applies to a disease manifestation that increases in scope or severity over the course of time, i.e., that worsens with age. Evidence: IEA. (OMIM:605229)
- Mild intellectual disability (HP:0001256): Mild intellectual disability (ID) is defined as a type of ID characterized by mildly sub-average adaptive functioning and intellectual functioning, with an intelligence quotient (IQ) the range of 50-69. Evidence: IEA. (OMIM:605229)
- Pes cavus (HP:0001761): An increase in height of the medial longitudinal arch of the foot that does not flatten on weight bearing (i.e., a distinctly hollow form of the sole of the foot when it is bearing weight). Evidence: IEA. (OMIM:605229)
- Babinski sign (HP:0003487): Upturning of the big toe (and sometimes fanning of the other toes) in response to stimulation of the sole of the foot. If the Babinski sign is present it can indicate damage to the corticospinal tract. Evidence: IEA. (OMIM:605229)
- Lower limb muscle weakness (HP:0007340): Weakness of the muscles of the legs. Evidence: IEA. (OMIM:605229)
- Adult onset (HP:0003581): Onset of disease manifestations in adulthood, defined here as at the age of 16 years or later. Evidence: TAS. (OMIM:605229)
- Spastic gait (HP:0002064): Spasticity is manifested by increased stretch reflex which is intensified with movement velocity. This results in excessive and inappropriate muscle activation which can contribute to muscle hypertonia. Spastic gait is characterized by manifestations such as muscle hypertonia, stiff knee, and circumduction of the leg. Evidence: IEA. (OMIM:605229)
- Lower limb spasticity (HP:0002061): Spasticity (velocity-dependent increase in tonic stretch reflexes with increased muscle tone and hyperexcitable tendon reflexes) in the muscles of the lower limbs, hips, and pelvis. Evidence: IEA. (OMIM:605229)
- Motor axonal neuropathy (HP:0007002): Progressive impairment of function of motor axons with muscle weakness, atrophy, and cramps. The deficits are length-dependent, meaning that muscles innervated by the longest nerves are affected first, so that for instance the arms are affected at a later age than the onset of deficits involving the lower leg. Evidence: IEA. (OMIM:605229)
- Autosomal recessive inheritance (HP:0000007): A mode of inheritance that is observed for traits related to a gene encoded on one of the autosomes (i.e., the human chromosomes 1-22) in which a trait manifests in individuals with two pathogenic alleles, either homozygotes (two copies of the same mutant allele) or compound heterozygotes (whereby each copy of a gene has a distinct mutant allele). Evidence: IEA. (OMIM:605229)
- Spastic paraplegia (HP:0001258): Complete loss of the ability to move the lower limbs accompanied by spasticity of the lower limbs. Evidence: TAS. (OMIM:605229)
- Hyperreflexia (HP:0001347): Hyperreflexia is the presence of hyperactive stretch reflexes of the muscles. Evidence: IEA. (OMIM:605229)
These phenotypes are associated with the disease hereditary spastic paraplegia 14 (OMIM:605229).